Phenotypes associated with the disease hearing loss, autosomal dominant 79 (OMIM:619086):
- Abnormal vestibular function (HP:0001751): An abnormality of the functioning of the vestibular apparatus. Evidence: PCS. Frequency: 0/19. (PMID:31972369)
- Progressive sensorineural hearing impairment (HP:0000408): A progressive form of sensorineural hearing impairment. Evidence: PCS. Frequency: 19/19. Onset: Adult onset (HP:0003581). (PMID:31972369)
- Adult onset (HP:0003581): Onset of disease manifestations in adulthood, defined here as at the age of 16 years or later. Evidence: PCS. Frequency: 19/19. (PMID:31972369)
- Autosomal dominant inheritance (HP:0000006): A mode of inheritance that is observed for traits related to a gene encoded on one of the autosomes (i.e., the human chromosomes 1-22) in which a trait manifests in heterozygotes. In the context of medical genetics, an autosomal dominant disorder is caused when a single copy of the mutant allele is present. Males and females are affected equally, and can both transmit the disorder with a risk of 50% for each child of inheriting the mutant allele. Evidence: PCS. (PMID:31972369)